- Intellectual disability (HP:0001249): The term intellectual disability or intellectual developmental disorder is used to describe significantly sub-average intellectual and adaptive functioning based on clinical assessment and as measured by individually administered, appropriately normed, standardized and validated tests of intellectual functioning and adaptive behavior, with onset during the developmental period from infancy through adolescence. Evidence: TAS. Frequency: Very frequent (HP:0040281). (ORPHA:352577)
- Global developmental delay (HP:0001263): A delay in the achievement of motor or mental milestones in the domains of development of a child, including motor skills, speech and language, cognitive skills, and social and emotional skills. This term should only be used to describe children younger than five years of age. Evidence: TAS. Frequency: Very frequent (HP:0040281). (ORPHA:352577)
- Abnormal speech pattern (HP:0002167): An abnormality in the sound (volume) or cadence (rate) of speech. Evidence: TAS. Frequency: Very frequent (HP:0040281). (ORPHA:352577)
- Feeding difficulties in infancy (HP:0008872): Impaired feeding performance of an infant as manifested by difficulties such as weak and ineffective sucking, brief bursts of sucking, and falling asleep during sucking. There may be difficulties with chewing or maintaining attention. Evidence: TAS. Frequency: Very frequent (HP:0040281). (ORPHA:352577)
- Floppy infant (HP:0008947): Floppiness/hypotonia is defined as reduced resistance to passive movement of joints. Physical examination of floppy/hypotonic infants shows head lag, lack of shoulder and elbow muscle contraction on traction response, inability to tighten the shoulder girdle muscles (or slipping through) when held under the axillae, scarf sign (when the arm is pulled to the opposite side, the arm wraps around the neck with the elbow crossing midline), hyperdorsiflexion of the feet, easy apposition of the thumb against the forearm, feet touching the cheek with ease and without discomfort, frog leg position, and inverted U sign on ventral suspension (head, arms, and legs hanging down without elbow or knee flexion and the trunk rounded in a dome shape). Evidence: TAS. Frequency: Very frequent (HP:0040281). (ORPHA:352577)
- Microcephaly (HP:0000252): Head circumference below 2 standard deviations below the mean for age and gender. Evidence: TAS. Frequency: Frequent (HP:0040282). (ORPHA:352577)
- Strabismus (HP:0000486): A misalignment of the eyes so that the visual axes deviate from bifoveal fixation. The classification of strabismus may be based on a number of features including the relative position of the eyes, whether the deviation is latent or manifest, intermittent or constant, concomitant or otherwise and according to the age of onset and the relevance of any associated refractive error. Evidence: TAS. Frequency: Frequent (HP:0040282). (ORPHA:352577)
- Autistic behavior (HP:0000729): Persistent deficits in social interaction and communication and interaction as well as a markedly restricted repertoire of activity and interest as well as repetitive patterns of behavior. Evidence: TAS. Frequency: Frequent (HP:0040282). (ORPHA:352577)
- Abnormality of the skeletal system (HP:0000924): An abnormality of the skeletal system. Evidence: TAS. Frequency: Frequent (HP:0040282). (ORPHA:352577)
- Absent speech (HP:0001344): Complete lack of development of speech and language abilities. Evidence: TAS. Frequency: Frequent (HP:0040282). (ORPHA:352577)
- Profound intellectual disability (HP:0002187): Profound intellectual disability (ID) is defined as a type of ID characterized by profoundly sub-average adaptive functioning and intellectual functioning, with an intelligence quotient (IQ) below 20. Evidence: TAS. Frequency: Frequent (HP:0040282). (ORPHA:352577)
- High, narrow palate (HP:0002705): The presence of a high and narrow palate. Evidence: TAS. Frequency: Frequent (HP:0040282). (ORPHA:352577)
- Severe intellectual disability (HP:0010864): Severe intellectual disability (ID) is defined as a type of ID characterized by severely sub-average adaptive functioning and intellectual functioning, with an intelligence quotient (IQ) the range of 20-34. Evidence: TAS. Frequency: Frequent (HP:0040282). (ORPHA:352577)
- Open mouth (HP:0000194): A facial appearance characterized by a permanently or nearly permanently opened mouth. Evidence: TAS. Frequency: Occasional (HP:0040283). (ORPHA:352577)
- Everted lower lip vermilion (HP:0000232): An abnormal configuration of the lower lip such that it is turned outward i.e., everted, with the Inner aspect of the lower lip vermilion (normally opposing the teeth) being visible in a frontal view. Evidence: TAS. Frequency: Occasional (HP:0040283). (ORPHA:352577)
- Dolichocephaly (HP:0000268): An abnormality of skull shape characterized by a increased anterior-posterior diameter, i.e., an increased antero-posterior dimension of the skull. Cephalic index less than 76%. Alternatively, an apparently increased antero-posterior length of the head compared to width. Often due to premature closure of the sagittal suture. Evidence: TAS. Frequency: Occasional (HP:0040283). (ORPHA:352577)
- Hypertelorism (HP:0000316): Interpupillary distance more than 2 SD above the mean (alternatively, the appearance of an increased interpupillary distance or widely spaced eyes). Evidence: TAS. Frequency: Occasional (HP:0040283). (ORPHA:352577)
- Bulbous nose (HP:0000414): Increased volume and globular shape of the anteroinferior aspect of the nose. Evidence: TAS. Frequency: Occasional (HP:0040283). (ORPHA:352577)
- Prominent nasal bridge (HP:0000426): Anterior positioning of the nasal root in comparison to the usual positioning for age. Evidence: TAS. Frequency: Occasional (HP:0040283). (ORPHA:352577)
- Underdeveloped nasal alae (HP:0000430): Thinned, deficient, or excessively arched ala nasi. Evidence: TAS. Frequency: Occasional (HP:0040283). (ORPHA:352577)
- Downslanted palpebral fissures (HP:0000494): The palpebral fissure inclination is more than two standard deviations below the mean. Evidence: TAS. Frequency: Occasional (HP:0040283). (ORPHA:352577)
- Upslanted palpebral fissure (HP:0000582): The palpebral fissure inclination is more than two standard deviations above the mean for age (objective); or, the inclination of the palpebral fissure is greater than typical for age. Evidence: TAS. Frequency: Occasional (HP:0040283). (ORPHA:352577)
- Synophrys (HP:0000664): Meeting of the medial eyebrows in the midline. Evidence: TAS. Frequency: Occasional (HP:0040283). (ORPHA:352577)
- Dental crowding (HP:0000678): Changes in alignment of teeth in the dental arch. Evidence: TAS. Frequency: Occasional (HP:0040283). (ORPHA:352577)
- Arachnodactyly (HP:0001166): Abnormally long and slender fingers (spider fingers). Evidence: TAS. Frequency: Occasional (HP:0040283). (ORPHA:352577)
- Seizure (HP:0001250): A seizure is an intermittent abnormality of nervous system physiology characterized by a transient occurrence of signs and/or symptoms due to abnormal excessive or synchronous neuronal activity in the brain. Evidence: TAS. Frequency: Occasional (HP:0040283). (ORPHA:352577)
- Hypertonia (HP:0001276): A condition in which there is increased muscle tone so that arms or legs, for example, are stiff and difficult to move. Evidence: TAS. Frequency: Occasional (HP:0040283). (ORPHA:352577)
- Cerebellar vermis hypoplasia (HP:0001320): Underdevelopment of the vermis of cerebellum. Evidence: TAS. Frequency: Occasional (HP:0040283). (ORPHA:352577)
- Disproportionate tall stature (HP:0001519): A tall and slim body build with increased arm span to height ratio (>1.05) and a reduced upper-to-lower segment ratio (<0.85), i.e., unusually long arms and legs. The extremities as well as the hands and feet are unusually slim. Evidence: TAS. Frequency: Occasional (HP:0040283). (ORPHA:352577)
- Pes planus (HP:0001763): A foot where the longitudinal arch of the foot is in contact with the ground or floor when the individual is standing; or, in a patient lying supine, a foot where the arch is in contact with the surface of a flat board pressed against the sole of the foot by the examiner with a pressure similar to that expected from weight bearing; or, the height of the arch is reduced. Evidence: TAS. Frequency: Occasional (HP:0040283). (ORPHA:352577)
- Moderate intellectual disability (HP:0002342): Moderate intellectual disability (ID) is defined as a type of ID characterized by moderately sub-average adaptive functioning and intellectual functioning, with an intelligence quotient (IQ) the range of 35-49. Evidence: TAS. Frequency: Occasional (HP:0040283). (ORPHA:352577)
- Sleep disturbance (HP:0002360): An abnormal pattern in the quality, quantity, or characteristics of sleep. Evidence: TAS. Frequency: Occasional (HP:0040283). (ORPHA:352577)
- Abnormal cerebral white matter morphology (HP:0002500): An abnormality of the cerebral white matter. Evidence: TAS. Frequency: Occasional (HP:0040283). (ORPHA:352577)
- Inability to walk (HP:0002540): Incapability to ambulate. Evidence: TAS. Frequency: Occasional (HP:0040283). (ORPHA:352577)
- Highly arched eyebrow (HP:0002553): Increased height of the central portion of the eyebrow, forming a crescent, semicircular, or inverted U shape. Evidence: TAS. Frequency: Occasional (HP:0040283). (ORPHA:352577)
- Scoliosis (HP:0002650): The presence of an abnormal lateral curvature of the spine. Evidence: TAS. Frequency: Occasional (HP:0040283). (ORPHA:352577)
- Long nose (HP:0003189): Distance from nasion to subnasale more than two standard deviations above the mean, or alternatively, an apparently increased length from the nasal root to the nasal base. Evidence: TAS. Frequency: Occasional (HP:0040283). (ORPHA:352577)
- Decreased facial expression (HP:0004673): A reduced degree of voluntary and involuntary facial movements involved in responded to others or expressing emotions. Evidence: TAS. Frequency: Occasional (HP:0040283). (ORPHA:352577)
- Low hanging columella (HP:0009765): Columella extending inferior to the level of the nasal base, when viewed from the side. Evidence: TAS. Frequency: Occasional (HP:0040283). (ORPHA:352577)
- Prominent forehead (HP:0011220): Forward prominence of the entire forehead, due to protrusion of the frontal bone. Evidence: TAS. Frequency: Occasional (HP:0040283). (ORPHA:352577)
- Recurrent hand flapping (HP:0100023): A type of repetitive behavior in which the affected individual repeatedly waves the hands and/or arms rhythmically. Evidence: TAS. Frequency: Occasional (HP:0040283). (ORPHA:352577)
These phenotypes are associated with the disease Bainbridge-Ropers syndrome (ORPHA:352577).